Phenotypes associated with the disease Leber congenital amaurosis 19 (OMIM:618513):
- Nystagmus (HP:0000639): Rhythmic, involuntary oscillations of one or both eyes related to abnormality in fixation, conjugate gaze, or vestibular mechanisms. Evidence: PCS. Frequency: 1/2. (PMID:30573563)
- Autosomal recessive inheritance (HP:0000007): A mode of inheritance that is observed for traits related to a gene encoded on one of the autosomes (i.e., the human chromosomes 1-22) in which a trait manifests in individuals with two pathogenic alleles, either homozygotes (two copies of the same mutant allele) or compound heterozygotes (whereby each copy of a gene has a distinct mutant allele). Evidence: PCS. (PMID:30573563)
- Retinal degeneration (HP:0000546): A nonspecific term denoting progressive loss of the retinal pigment epithelium (RPE) and/or neurosensory retinal cells. Evidence: PCS. (PMID:30573563)
- Visual impairment (HP:0000505): Visual impairment (or vision impairment) is vision loss (of a person) to such a degree as to qualify as an additional support need through a significant limitation of visual capability resulting from either disease, trauma, or congenital or degenerative conditions that cannot be corrected by conventional means, such as refractive correction, medication, or surgery. Evidence: PCS. Onset: Childhood onset (HP:0011463). (PMID:30573563)
- Optic disc pallor (HP:0000543): A pale yellow discoloration of the optic disc (the area of the optic nerve head in the retina). The optic disc normally has a pinkish hue with a central yellowish depression. Evidence: PCS. Frequency: 2/2. (PMID:30573563)
- Attenuation of retinal blood vessels (HP:0007843): Narrowing of the retinal blood vessels, both arterioles and venules. Evidence: PCS. (PMID:30573563)
- Decreased light- and dark-adapted electroretinogram amplitude (HP:0000654): Decreased amplitude of eletrical response upon electroretinography. Evidence: PCS. (PMID:30573563)